- Abnormality of the genitourinary system (HP:0000119): The presence of any abnormality of the genitourinary system. Evidence: TAS. Frequency: Occasional (HP:0040283). (ORPHA:2456)
- Supernumerary nipple (HP:0002558): Presence of more than two nipples. Evidence: TAS. Frequency: Very frequent (HP:0040281). (ORPHA:2456)
These phenotypes are associated with the disease Familial supernumerary nipples (ORPHA:2456).